Phenotypes associated with the disease amelogenesis imperfecta type 1B (OMIM:104500):
- Amelogenesis imperfecta (HP:0000705): A developmental dysplasia of the dental enamel. Evidence: IEA. (OMIM:104500)
- Autosomal dominant inheritance (HP:0000006): A mode of inheritance that is observed for traits related to a gene encoded on one of the autosomes (i.e., the human chromosomes 1-22) in which a trait manifests in heterozygotes. In the context of medical genetics, an autosomal dominant disorder is caused when a single copy of the mutant allele is present. Males and females are affected equally, and can both transmit the disorder with a risk of 50% for each child of inheriting the mutant allele. Evidence: IEA. (OMIM:104500)